Phenotypes associated with the disease Char syndrome (OMIM:169100):
- Highly arched eyebrow (HP:0002553): Increased height of the central portion of the eyebrow, forming a crescent, semicircular, or inverted U shape. Evidence: PCS. (OMIM:169100)
- Strabismus (HP:0000486): A misalignment of the eyes so that the visual axes deviate from bifoveal fixation. The classification of strabismus may be based on a number of features including the relative position of the eyes, whether the deviation is latent or manifest, intermittent or constant, concomitant or otherwise and according to the age of onset and the relevance of any associated refractive error. Evidence: IEA. (OMIM:169100)
- Mild intellectual disability (HP:0001256): Mild intellectual disability (ID) is defined as a type of ID characterized by mildly sub-average adaptive functioning and intellectual functioning, with an intelligence quotient (IQ) the range of 50-69. Evidence: IEA. (OMIM:169100)
- Thick eyebrow (HP:0000574): Increased density/number and/or increased diameter of eyebrow hairs. Evidence: PCS. (OMIM:169100)
- Parasomnia (HP:0025234): A clinically observable or self-reported abnormal behavior, experience, or physiological event that occurs in association with sleep, specific sleep stages, or sleep-wake transitions. Evidence: TAS. (OMIM:169100)
- Global developmental delay (HP:0001263): A delay in the achievement of motor or mental milestones in the domains of development of a child, including motor skills, speech and language, cognitive skills, and social and emotional skills. This term should only be used to describe children younger than five years of age. Evidence: TAS. (OMIM:169100)
- Ptosis (HP:0000508): The upper eyelid margin is positioned 3 mm or more lower than usual and covers the superior portion of the iris (objective); or, the upper lid margin obscures at least part of the pupil (subjective). Evidence: IEA. (OMIM:169100)
- Distal fifth finger symphalangism (HP:0009244): Fusion of the terminal/distal and middle phalanges of the 5th finger. Evidence: PCS. (OMIM:169100)
- Hypertelorism (HP:0000316): Interpupillary distance more than 2 SD above the mean (alternatively, the appearance of an increased interpupillary distance or widely spaced eyes). Evidence: IEA. (OMIM:169100)
- Broad forehead (HP:0000337): Width of the forehead or distance between the frontotemporales is more than two standard deviations above the mean (objective); or apparently increased distance between the two sides of the forehead. Evidence: IEA. (OMIM:169100)
- Triangular mouth (HP:0000207): The presence of a triangular form of the mouth. Evidence: IEA. (OMIM:169100)
- Clinodactyly of the 5th finger (HP:0004209): Clinodactyly refers to a bending or curvature of the fifth finger in the radial direction (i.e., towards the 4th finger). Evidence: IEA. (OMIM:169100)
- Protruding ear (HP:0000411): Angle formed by the plane of the ear and the mastoid bone greater than the 97th centile for age (objective); or, outer edge of the helix more than 2 cm from the mastoid at the point of maximum distance (objective). Evidence: IEA. (OMIM:169100)
- Broad nasal tip (HP:0000455): Increase in width of the nasal tip. Evidence: IEA. (OMIM:169100)
- Patent ductus arteriosus (HP:0001643): In utero, the ductus arteriosus (DA) serves to divert ventricular output away from the lungs and toward the placenta by connecting the main pulmonary artery to the descending aorta. A patent ductus arteriosus (PDA) in the first 3 days of life is a physiologic shunt in healthy term and preterm newborn infants, and normally is substantially closed within about 24 hours after bith and completely closed after about three weeks. Failure of physiologcal closure is referred to a persistent or patent ductus arteriosus (PDA). Depending on the degree of left-to-right shunting, PDA can have clinical consequences. Evidence: IEA. (OMIM:169100)
- Short philtrum (HP:0000322): Distance between nasal base and midline upper lip vermilion border more than 2 SD below the mean. Alternatively, an apparently decreased distance between nasal base and midline upper lip vermilion border. Evidence: IEA. (OMIM:169100)
- Autosomal dominant inheritance (HP:0000006): A mode of inheritance that is observed for traits related to a gene encoded on one of the autosomes (i.e., the human chromosomes 1-22) in which a trait manifests in heterozygotes. In the context of medical genetics, an autosomal dominant disorder is caused when a single copy of the mutant allele is present. Males and females are affected equally, and can both transmit the disorder with a risk of 50% for each child of inheriting the mutant allele. Evidence: IEA. (OMIM:169100)
- Low-set ears (HP:0000369): Upper insertion of the ear to the scalp below an imaginary horizontal line drawn between the inner canthi of the eye and extending posteriorly to the ear. Evidence: IEA. (OMIM:169100)